Phenotypes associated with the disease chondrocalcinosis 1 (OMIM:600668):
- Chondrocalcinosis (HP:0000934): Radiographic evidence of articular calcification that represent calcium pyrophosphate depositions in soft tissue surrounding joints and at the insertions of tendons near joints (Entheses/Sharpey fibers) . Evidence: IEA. (OMIM:600668)
- Osteoarthritis (HP:0002758): Degeneration (wear and tear) of articular cartilage, i.e., of the joint surface. Joint degeneration may be accompanied by osteophytes (bone overgrowth), narrowing of the joint space, regions of sclerosis at the joint surface, or joint deformity. Evidence: IEA. (OMIM:600668)
- Autosomal dominant inheritance (HP:0000006): A mode of inheritance that is observed for traits related to a gene encoded on one of the autosomes (i.e., the human chromosomes 1-22) in which a trait manifests in heterozygotes. In the context of medical genetics, an autosomal dominant disorder is caused when a single copy of the mutant allele is present. Males and females are affected equally, and can both transmit the disorder with a risk of 50% for each child of inheriting the mutant allele. Evidence: IEA. (OMIM:600668)